Phenotypes associated with the disease spastic paraplegia 90A, autosomal dominant (OMIM:620416):
- Axial hypotonia (HP:0008936): Muscular hypotonia (abnormally low muscle tone) affecting the musculature of the trunk. Evidence: PCS. Frequency: 2/2. (PMID:36718090)
- Dysphagia (HP:0002015): Difficulty in swallowing. Evidence: PCS. Frequency: 1/2. (PMID:36718090)
- Absent speech (HP:0001344): Complete lack of development of speech and language abilities. Evidence: PCS. Frequency: 1/2. (PMID:36718090)
- Scoliosis (HP:0002650): The presence of an abnormal lateral curvature of the spine. Evidence: PCS. Frequency: 1/1. (PMID:36718090)
- Tethered cord (HP:0002144): During normal embryological development, the spinal cord first occupies the entire length of the vertebral column but goes on to assume a position at the level of L1 due to differential growth of the conus medullaris and the vertebral column. The filum terminale is a slender, threadlike structure that remains after the normal regression of the distal embryonic spinal cord and attaches the spinal cord to the coccyx. A tethered cord results if there is a thickened rope-like filum terminale which anchors the cord at the level of L2 or below, potentially causing neurologic signs owing to abnormal tension on the spinal cord. Evidence: PCS. Frequency: 1/2. (PMID:36718090)
- Delayed speech and language development (HP:0000750): A degree of language development that is significantly below the norm for a child of a specified age. Evidence: PCS. Frequency: 1/1. (PMID:36718090)
- Short stature (HP:0004322): A height below that which is expected according to age and gender norms. Although there is no universally accepted definition of short stature, many refer to "short stature" as height more than 2 standard deviations below the mean for age and gender (or below the 3rd percentile for age and gender dependent norms). Evidence: PCS. Frequency: 2/2. (PMID:36718090)
- Delayed ability to walk (HP:0031936): A failure to achieve the ability to walk at an appropriate developmental stage. Most children learn to walk in a series of stages, and learn to walk short distances independently between 12 and 15 months. Evidence: PCS. Frequency: 2/2. (PMID:36718090)
- Dystonia (HP:0001332): An abnormally increased muscular tone that causes fixed abnormal postures. There is a slow, intermittent twisting motion that leads to exaggerated turning and posture of the extremities and trunk. Evidence: PCS. Frequency: 1/2. (PMID:36718090)
- Nevus flammeus (HP:0001052): A congenital vascular malformation consisting of superficial and deep dilated capillaries in the skin which produce a reddish to purplish discolouration of the skin. Evidence: PCS. Frequency: 2/2. (PMID:36718090)
- Seizure (HP:0001250): A seizure is an intermittent abnormality of nervous system physiology characterized by a transient occurrence of signs and/or symptoms due to abnormal excessive or synchronous neuronal activity in the brain. Evidence: PCS. Frequency: 0/2. (PMID:36718090)
- Sleep disturbance (HP:0002360): An abnormal pattern in the quality, quantity, or characteristics of sleep. Evidence: PCS. Frequency: 1/2. (PMID:36718090)
- Gastroesophageal reflux (HP:0002020): A condition in which the stomach contents leak backwards from the stomach into the esophagus through the lower esophageal sphincter. Evidence: PCS. Frequency: 1/2. (PMID:36718090)
- Spastic gait (HP:0002064): Spasticity is manifested by increased stretch reflex which is intensified with movement velocity. This results in excessive and inappropriate muscle activation which can contribute to muscle hypertonia. Spastic gait is characterized by manifestations such as muscle hypertonia, stiff knee, and circumduction of the leg. Evidence: PCS. Frequency: 1/1. (PMID:36718090)
- Infantile onset (HP:0003593): Onset of signs or symptoms of disease between 28 days to one year of life. Evidence: PCS. Frequency: 2/2. (PMID:36718090)
- Failure to thrive (HP:0001508): Failure to thrive (FTT) refers to a child whose physical growth is substantially below the norm. Evidence: PCS. Frequency: 1/2. (PMID:36718090)
- Appendicular spasticity (HP:0034353): A type of spasticity that affects one or more limbs (arms or legs). Evidence: PCS. Frequency: 2/2. (PMID:36718090)
- Sensorineural hearing impairment (HP:0000407): A type of hearing impairment in one or both ears related to an abnormal functionality of the cochlear nerve. Evidence: PCS. Frequency: 1/2. (PMID:36718090)
- Drooling (HP:0002307): Habitual flow of saliva out of the mouth. Evidence: PCS. Frequency: 1/2. (PMID:36718090)
- Macrocephaly (HP:0000256): Occipitofrontal (head) circumference greater than 97th centile compared to appropriate, age matched, sex-matched normal standards. Alternatively, a apparently increased size of the cranium. Evidence: PCS. Frequency: 1/2. (PMID:36718090)
- Intellectual disability (HP:0001249): The term intellectual disability or intellectual developmental disorder is used to describe significantly sub-average intellectual and adaptive functioning based on clinical assessment and as measured by individually administered, appropriately normed, standardized and validated tests of intellectual functioning and adaptive behavior, with onset during the developmental period from infancy through adolescence. Evidence: PCS. Frequency: 2/2. (PMID:36718090)
- Autosomal dominant inheritance (HP:0000006): A mode of inheritance that is observed for traits related to a gene encoded on one of the autosomes (i.e., the human chromosomes 1-22) in which a trait manifests in heterozygotes. In the context of medical genetics, an autosomal dominant disorder is caused when a single copy of the mutant allele is present. Males and females are affected equally, and can both transmit the disorder with a risk of 50% for each child of inheriting the mutant allele. Evidence: PCS. (PMID:36718090)